- Bimanual synkinesia (HP:0001335): Involuntary movements of one hand that accompany and mirror intentional movements of the opposite hand. Evidence: PCS. (PMID:28945198)
- Autosomal dominant inheritance (HP:0000006): A mode of inheritance that is observed for traits related to a gene encoded on one of the autosomes (i.e., the human chromosomes 1-22) in which a trait manifests in heterozygotes. In the context of medical genetics, an autosomal dominant disorder is caused when a single copy of the mutant allele is present. Males and females are affected equally, and can both transmit the disorder with a risk of 50% for each child of inheriting the mutant allele. Evidence: PCS. (PMID:28945198)
These phenotypes are associated with the disease mirror movements 4 (OMIM:618264).